- Hepatic steatosis (HP:0001397): Steatosis is a term used to denote lipid accumulation within hepatocytes. Evidence: PCS. Frequency: 1/1. (PMID:31355908)
- Short stature (HP:0004322): A height below that which is expected according to age and gender norms. Although there is no universally accepted definition of short stature, many refer to "short stature" as height more than 2 standard deviations below the mean for age and gender (or below the 3rd percentile for age and gender dependent norms). Evidence: PCS. Frequency: 1/1. (PMID:31355908)
- Decreased muscle mass (HP:0003199). Evidence: PCS. Frequency: 1/1. (PMID:31355908)
- Generalized hypotonia (HP:0001290): Generalized muscular hypotonia (abnormally low muscle tone). Evidence: PCS. Frequency: 1/1. (PMID:31355908)
- Hypoalbuminemia (HP:0003073): The concentration of albumin in the blood circulation is below the lower limit of normal. Evidence: PCS. Frequency: 1/1. (PMID:31355908)
- Fetal onset (HP:0011461): Onset prior to birth but after 8 weeks of embryonic development (corresponding to a gestational age of 10 weeks). Evidence: PCS. (PMID:31355908)
- Abnormal pulmonary interstitial morphology (HP:0006530): Abnormality of the lung parenchyma extending to the pulmonary interstitium and leading to diffuse pulmonary fibrosis. Evidence: PCS. Frequency: 1/1. (PMID:31355908)
- Feeding difficulties in infancy (HP:0008872): Impaired feeding performance of an infant as manifested by difficulties such as weak and ineffective sucking, brief bursts of sucking, and falling asleep during sucking. There may be difficulties with chewing or maintaining attention. Evidence: PCS. Frequency: 1/1. (PMID:31355908)
- Elevated circulating hepatic transaminase concentration (HP:0002910): Elevations of the levels of SGOT and SGPT in the serum. SGOT (serum glutamic oxaloacetic transaminase) and SGPT (serum glutamic pyruvic transaminase) are transaminases primarily found in the liver and heart and are released into the bloodstream as the result of liver or heart damage. SGOT and SGPT are used clinically mainly as markers of liver damage. Evidence: PCS. Frequency: 1/1. (PMID:31355908)
- Exercise intolerance (HP:0003546): A functional motor deficit where individuals whose responses to the challenges of exercise fail to achieve levels considered normal for their age and gender. Evidence: PCS. Frequency: 1/1. (PMID:31355908)
- Periventricular cysts (HP:0007109). Evidence: PCS. Frequency: 1/1. (PMID:31355908)
- Oligohydramnios (HP:0001562): Diminished amniotic fluid volume in pregnancy. Evidence: PCS. Frequency: 1/1. (PMID:31355908)
- Arachnodactyly (HP:0001166): Abnormally long and slender fingers (spider fingers). Evidence: PCS. Frequency: 1/1. (PMID:31355908)
- Microcephaly (HP:0000252): Head circumference below 2 standard deviations below the mean for age and gender. Evidence: PCS. Frequency: 1/1. (PMID:31355908)
- Hypertriglyceridemia (HP:0002155): An abnormal increase in the level of triglycerides in the blood. Evidence: PCS. Frequency: 1/1. (PMID:31355908)
- Scoliosis (HP:0002650): The presence of an abnormal lateral curvature of the spine. Evidence: PCS. Frequency: 1/1. (PMID:31355908)
- Joint hypermobility (HP:0001382): The capability that a joint (or a group of joints) has to move, passively and/or actively, beyond normal limits along physiological axes. Evidence: PCS. Frequency: 1/1. (PMID:31355908)
- Deeply set eye (HP:0000490): An eye that is more deeply recessed into the plane of the face than is typical. Evidence: PCS. Frequency: 1/1. (PMID:31355908)
- Global developmental delay (HP:0001263): A delay in the achievement of motor or mental milestones in the domains of development of a child, including motor skills, speech and language, cognitive skills, and social and emotional skills. This term should only be used to describe children younger than five years of age. Evidence: PCS. Frequency: 1/1. (PMID:31355908)
- Cough (HP:0012735): A sudden, audible expulsion of air from the lungs through a partially closed glottis, preceded by inhalation. Evidence: PCS. Frequency: 1/1. (PMID:31355908)
- Hypopituitarism (HP:0040075). Evidence: PCS. Frequency: 1/1. (PMID:31355908)
- Restrictive ventilatory defect (HP:0002091): A functional defect characterized by reduced total lung capacity (TLC) not associated with abnormalities of expiratory airflow or airway resistance. Spirometrically, a restrictive defect is defined as FEV1 (forced expiratory volume in 1 second) and FVC (forced vital capacity) less than 80 per cent. Restrictive lung disease may be caused by alterations in lung parenchyma or because of a disease of the pleura, chest wall, or neuromuscular apparatus. Evidence: PCS. Frequency: 1/1. (PMID:31355908)
- Autosomal recessive inheritance (HP:0000007): A mode of inheritance that is observed for traits related to a gene encoded on one of the autosomes (i.e., the human chromosomes 1-22) in which a trait manifests in individuals with two pathogenic alleles, either homozygotes (two copies of the same mutant allele) or compound heterozygotes (whereby each copy of a gene has a distinct mutant allele). Evidence: PCS. (PMID:31355908)
- Hypothyroidism (HP:0000821): Deficiency of thyroid hormone. Evidence: PCS. Frequency: 1/1. (PMID:31355908)
- Microcytic anemia (HP:0001935): A kind of anemia in which the volume of the red blood cells is reduced. Evidence: PCS. Frequency: 1/1. (PMID:31355908)
- Elfin facies (HP:0004428): This is a description previously used to describe a facial form characterized by a short, upturned nose, wide mouth, widely spaced eyes, and full cheeks. Because of the imprecision in this definition it is preferable to describe these features precisely. This term is retained because it was often used in the past, but it should not be used for new annotations. Evidence: PCS. Frequency: 1/1. (PMID:31355908)
- Hepatosplenomegaly (HP:0001433): Simultaneous enlargement of the liver and spleen. Evidence: PCS. Frequency: 1/1. (PMID:31355908)
These phenotypes are associated with the disease Rajab interstitial lung disease with brain calcifications 2 (OMIM:619013).